Phenotypes associated with the disease Paraparetic variant of Guillain-Barré syndrome (ORPHA:231445):
- Areflexia (HP:0001284): Absence of neurologic reflexes such as the knee-jerk reaction. Evidence: TAS. Frequency: Frequent (HP:0040282). (ORPHA:231445)
- Paraparesis (HP:0002385): Weakness or partial paralysis in the lower limbs. Evidence: TAS. Frequency: Frequent (HP:0040282). (ORPHA:231445)
- Peripheral axonal neuropathy (HP:0003477): An abnormality characterized by disruption of the normal functioning of peripheral axons. Evidence: TAS. Frequency: Frequent (HP:0040282). (ORPHA:231445)
- Impaired distal proprioception (HP:0006858): A loss or impairment of the sensation of the relative position of parts of the body and joint position occurring at distal joints. Evidence: TAS. Frequency: Frequent (HP:0040282). (ORPHA:231445)
- Sciatica (HP:0011868): Pain in the lower back and hip radiating in the distribution of the sciatic nerve. Evidence: TAS. Frequency: Frequent (HP:0040282). (ORPHA:231445)
- Pain (HP:0012531): An unpleasant sensory and emotional experience associated with actual or potential tissue damage, or described in terms of such damage. Evidence: TAS. Frequency: Frequent (HP:0040282). (ORPHA:231445)
- Increased CSF/serum albumin ratio (HP:0025459): An increase above normal limits of the ratio of the cerebrospinal fluid (CSF) albumin concentration to serum albumin concentration. Evidence: TAS. Frequency: Frequent (HP:0040282). (ORPHA:231445)
- Peripheral demyelination (HP:0011096): A loss of myelin from the internode regions along myelinated nerve fibers of the peripheral nervous system. Evidence: TAS. Frequency: Occasional (HP:0040283). (ORPHA:231445)
- Recurrent acute respiratory tract infection (HP:0011948): A history of repeated acute infections of the upper or lower respiratory tract. Evidence: TAS. Frequency: Occasional (HP:0040283). (ORPHA:231445)
Not associated with this disease:
- Urinary bladder sphincter dysfunction (HP:0002839): Abnormal function of a sphincter of the urinary bladder. Evidence: TAS. (ORPHA:231445)